Phenotypes associated with the disease autoinflammation-PLCG2-associated antibody deficiency-immune dysregulation (OMIM:614878):
- Decreased circulating IgM concentration (HP:0002850): An abnormally decreased level of immunoglobulin M (IgM) in blood. Evidence: PCS. Frequency: 2/2. (PMID:23000145)
- Interstitial pneumonitis (HP:0006515). Evidence: PCS. Frequency: 2/2. (PMID:23000145)
- Recurrent sinopulmonary infections (HP:0005425): An increased susceptibility to infections involving both the paranasal sinuses and the lungs, as manifested by a history of recurrent sinopulmonary infections. Evidence: PCS. Frequency: 2/2. (PMID:23000145)
- Enterocolitis (HP:0004387): An inflammation of the colon and small intestine. However, most conditions are either categorized as Enteritis (inflammation of the small intestine) or Colitis (inflammation of the large intestine). Evidence: PCS. Frequency: 2/2. (PMID:23000145)
- Decreased class-switched memory B cell proportion (HP:0030388): A reduction in the normal proportion of class-switched memory B cells (CD19+/CD27+/IgM+/IgD+) relative to the total number of B cells. Marginal zone B cells undergo limited somatic hypermutation and produce high-affinity IgM and some IgG, whereas class-switched memory B cells synthetize IgG, IgM, and IgA. Evidence: PCS. Frequency: 2/2. (PMID:23000145)
- Infantile onset (HP:0003593): Onset of signs or symptoms of disease between 28 days to one year of life. Evidence: PCS. Frequency: 2/2. (PMID:23000145)
- Erythema (HP:0010783): Redness of the skin, caused by hyperemia of the capillaries in the lower layers of the skin. Evidence: PCS. Frequency: 2/2. (PMID:23000145)
- Unusual bronchiolitis (HP:0011950): Increased susceptibility to bronchiolitis (inflammation of the bronchioles) as manifested by recurrent or severe epsiodes of bronchiolitis. Evidence: PCS. Frequency: 2/2. (PMID:23000145)
- Ulcerative colitis (HP:0100279): A chronic inflammatory bowel disease that includes characteristic ulcers, or open sores, in the colon. The main symptom of active disease is usually constant diarrhea mixed with blood, of gradual onset and intermittent periods of exacerbated symptoms contrasting with periods that are relatively symptom-free. In contrast to Crohn's disease this special form of colitis begins in the distal parts of the rectum, spreads continually upwards and affects only mucose and submucose tissue of the colon. Evidence: PCS. Frequency: 1/2. (PMID:23000145)
- Arthralgia (HP:0002829): Joint pain. Evidence: PCS. Frequency: 2/2. (PMID:23000145)
- Cataract (HP:0000518): A cataract is an opacity or clouding that develops in the crystalline lens of the eye or in its capsule. Evidence: PCS. Frequency: 1/2. (PMID:23000145)
- Cellulitis (HP:0100658): A bacterial infection and inflammation of the skin und subcutaneous tissues. Evidence: PCS. Frequency: 2/2. (PMID:23000145)
- Immune dysregulation (HP:0002958): Altered immune function characterized by lymphoid proliferation, immune activation, and excessive autoreactivity often leading to autoimmune/inflammatory complications. Evidence: PCS. (PMID:23000145)
- Autosomal dominant inheritance (HP:0000006): A mode of inheritance that is observed for traits related to a gene encoded on one of the autosomes (i.e., the human chromosomes 1-22) in which a trait manifests in heterozygotes. In the context of medical genetics, an autosomal dominant disorder is caused when a single copy of the mutant allele is present. Males and females are affected equally, and can both transmit the disorder with a risk of 50% for each child of inheriting the mutant allele. Evidence: PCS. (PMID:23000145)
- Corneal erosion (HP:0200020): An erosion or abrasion of the cornea's outermost layer of epithelial cells. Evidence: PCS. Frequency: 1/2. (PMID:23000145)
- Decreased circulating IgA concentration (HP:0002720): Decreased levels of immunoglobulin A (IgA). Evidence: PCS. Frequency: 2/2. (PMID:23000145)